Phenotypes associated with the disease Cataract-hypertrichosis-intellectual disability syndrome (ORPHA:1375):
- Abnormal palate morphology (HP:0000174): Any abnormality of the palate, i.e., of roof of the mouth. Evidence: TAS. Frequency: Very frequent (HP:0040281). (ORPHA:1375)
- Developmental cataract (HP:0000519): A cataract that occurs congenitally as the result of a developmental defect, in contrast to the majority of cataracts that occur in adulthood as the result of degenerative changes of the lens. Evidence: TAS. Frequency: Very frequent (HP:0040281). (ORPHA:1375)
- Microdontia (HP:0000691): Decreased size of the teeth, which can be defined as a mesiodistal tooth diameter (width) more than 2 SD below mean. Alternatively, an apparently decreased maximum width of tooth. Evidence: TAS. Frequency: Very frequent (HP:0040281). (ORPHA:1375)
- Pectus excavatum (HP:0000767): A defect of the chest wall characterized by a depression of the sternum, giving the chest ("pectus") a caved-in ("excavatum") appearance. Evidence: TAS. Frequency: Very frequent (HP:0040281). (ORPHA:1375)
- Intellectual disability (HP:0001249): The term intellectual disability or intellectual developmental disorder is used to describe significantly sub-average intellectual and adaptive functioning based on clinical assessment and as measured by individually administered, appropriately normed, standardized and validated tests of intellectual functioning and adaptive behavior, with onset during the developmental period from infancy through adolescence. Evidence: TAS. Frequency: Very frequent (HP:0040281). (ORPHA:1375)
- Low posterior hairline (HP:0002162): Hair on the neck extends more inferiorly than usual. Evidence: TAS. Frequency: Very frequent (HP:0040281). (ORPHA:1375)
- Generalized hirsutism (HP:0002230): Abnormally increased hair growth over much of the entire body. Evidence: TAS. Frequency: Very frequent (HP:0040281). (ORPHA:1375)
- Depressed nasal bridge (HP:0005280): Posterior positioning of the nasal root in relation to the overall facial profile for age. Evidence: TAS. Frequency: Very frequent (HP:0040281). (ORPHA:1375)